Phenotypes associated with the disease 6q25.2q25.3 microdeletion syndrome (ORPHA:251056):
- Microcephaly (HP:0000252): Head circumference below 2 standard deviations below the mean for age and gender. Evidence: TAS. Frequency: Very frequent (HP:0040281). (ORPHA:251056)
- Sensorineural hearing impairment (HP:0000407): A type of hearing impairment in one or both ears related to an abnormal functionality of the cochlear nerve. Evidence: TAS. Frequency: Very frequent (HP:0040281). (ORPHA:251056)
- Mild intellectual disability (HP:0001256): Mild intellectual disability (ID) is defined as a type of ID characterized by mildly sub-average adaptive functioning and intellectual functioning, with an intelligence quotient (IQ) the range of 50-69. Evidence: TAS. Frequency: Very frequent (HP:0040281). (ORPHA:251056)
- Global developmental delay (HP:0001263): A delay in the achievement of motor or mental milestones in the domains of development of a child, including motor skills, speech and language, cognitive skills, and social and emotional skills. This term should only be used to describe children younger than five years of age. Evidence: TAS. Frequency: Very frequent (HP:0040281). (ORPHA:251056)
- High palate (HP:0000218): Height of the palate more than 2 SD above the mean (objective) or palatal height at the level of the first permanent molar more than twice the height of the teeth (subjective). Evidence: TAS. Frequency: Frequent (HP:0040282). (ORPHA:251056)
- Malar flattening (HP:0000272): Underdevelopment of the malar prominence of the jugal bone (zygomatic bone in mammals), appreciated in profile, frontal view, and/or by palpation. Evidence: TAS. Frequency: Frequent (HP:0040282). (ORPHA:251056)
- Epicanthus (HP:0000286): A fold of skin starting above the medial aspect of the upper eyelid and arching downward to cover, pass in front of and lateral to the medial canthus. Evidence: TAS. Frequency: Frequent (HP:0040282). (ORPHA:251056)
- Hypertelorism (HP:0000316): Interpupillary distance more than 2 SD above the mean (alternatively, the appearance of an increased interpupillary distance or widely spaced eyes). Evidence: TAS. Frequency: Frequent (HP:0040282). (ORPHA:251056)
- Posteriorly rotated ears (HP:0000358): A type of abnormal location of the ears in which the position of the ears is characterized by posterior rotation (the superior part of the ears is rotated towards the back of the head, and the inferior part of the ears towards the front). Evidence: TAS. Frequency: Frequent (HP:0040282). (ORPHA:251056)
- Abnormal pinna morphology (HP:0000377): An abnormality of the pinna, which is also referred to as the auricle or external ear. Evidence: TAS. Frequency: Frequent (HP:0040282). (ORPHA:251056)
- Wide nasal bridge (HP:0000431): Increased breadth of the nasal bridge (and with it, the nasal root). Evidence: TAS. Frequency: Frequent (HP:0040282). (ORPHA:251056)
- Abnormality of the eye (HP:0000478): Any abnormality of the eye, including location, spacing, and intraocular abnormalities. Evidence: TAS. Frequency: Frequent (HP:0040282). (ORPHA:251056)
- Downslanted palpebral fissures (HP:0000494): The palpebral fissure inclination is more than two standard deviations below the mean. Evidence: TAS. Frequency: Frequent (HP:0040282). (ORPHA:251056)
- Abnormality of vision (HP:0000504): Abnormality of eyesight (visual perception). Evidence: TAS. Frequency: Frequent (HP:0040282). (ORPHA:251056)
- Agenesis of corpus callosum (HP:0001274): Absence of the corpus callosum as a result of the failure of the corpus callosum to develop, which can be the result of a failure in any one of the multiple steps of callosal development including cellular proliferation and migration, axonal growth or glial patterning at the midline. Evidence: TAS. Frequency: Frequent (HP:0040282). (ORPHA:251056)
- Plagiocephaly (HP:0001357): Asymmetric head shape, which is usually a combination of unilateral occipital flattening with ipsilateral frontal prominence, leading to rhomboid cranial shape. Evidence: TAS. Frequency: Frequent (HP:0040282). (ORPHA:251056)
- Failure to thrive (HP:0001508): Failure to thrive (FTT) refers to a child whose physical growth is substantially below the norm. Evidence: TAS. Frequency: Frequent (HP:0040282). (ORPHA:251056)
- Short stature (HP:0004322): A height below that which is expected according to age and gender norms. Although there is no universally accepted definition of short stature, many refer to "short stature" as height more than 2 standard deviations below the mean for age and gender (or below the 3rd percentile for age and gender dependent norms). Evidence: TAS. Frequency: Frequent (HP:0040282). (ORPHA:251056)
- Abnormal nervous system morphology (HP:0012639): A structural anomaly of the nervous system. Evidence: TAS. Frequency: Frequent (HP:0040282). (ORPHA:251056)
- Cleft palate (HP:0000175): Cleft palate is a developmental defect of the palate resulting from a failure of fusion of the palatine processes and manifesting as a separation of the roof of the mouth (soft and hard palate). Evidence: TAS. Frequency: Occasional (HP:0040283). (ORPHA:251056)
- Long philtrum (HP:0000343): Distance between nasal base and midline upper lip vermilion border more than 2 SD above the mean. Alternatively, an apparently increased distance between nasal base and midline upper lip vermilion border. Evidence: TAS. Frequency: Occasional (HP:0040283). (ORPHA:251056)
- Micrognathia (HP:0000347): Developmental hypoplasia of the mandible. Evidence: TAS. Frequency: Occasional (HP:0040283). (ORPHA:251056)
- Upslanted palpebral fissure (HP:0000582): The palpebral fissure inclination is more than two standard deviations above the mean for age (objective); or, the inclination of the palpebral fissure is greater than typical for age. Evidence: TAS. Frequency: Occasional (HP:0040283). (ORPHA:251056)
- Seizure (HP:0001250): A seizure is an intermittent abnormality of nervous system physiology characterized by a transient occurrence of signs and/or symptoms due to abnormal excessive or synchronous neuronal activity in the brain. Evidence: TAS. Frequency: Occasional (HP:0040283). (ORPHA:251056)
- Hypotonia (HP:0001252): Hypotonia is an abnormally low muscle tone (the amount of tension or resistance to movement in a muscle). Even when relaxed, muscles have a continuous and passive partial contraction which provides some resistance to passive stretching. Hypotonia thus manifests as diminished resistance to passive stretching. Hypotonia is not the same as muscle weakness, although the two conditions can co-exist. Evidence: TAS. Frequency: Occasional (HP:0040283). (ORPHA:251056)
- Neonatal hypotonia (HP:0001319): Muscular hypotonia (abnormally low muscle tone) manifesting in the neonatal period. Evidence: TAS. Frequency: Occasional (HP:0040283). (ORPHA:251056)
- Rocker bottom foot (HP:0001838): The presence of both a prominent heel and a convex contour of the sole. Evidence: TAS. Frequency: Occasional (HP:0040283). (ORPHA:251056)
- Ventriculomegaly (HP:0002119): An increase in size of the ventricular system of the brain. Evidence: TAS. Frequency: Occasional (HP:0040283). (ORPHA:251056)
- External genital hypoplasia (HP:0003241): Underdevelopment of part or all of the external reproductive organs. Evidence: TAS. Frequency: Occasional (HP:0040283). (ORPHA:251056)
- Clinodactyly of the 5th finger (HP:0004209): Clinodactyly refers to a bending or curvature of the fifth finger in the radial direction (i.e., towards the 4th finger). Evidence: TAS. Frequency: Occasional (HP:0040283). (ORPHA:251056)
- Abnormal cardiovascular system morphology (HP:0030680): Any structural anomaly of the heart and blood vessels. Evidence: TAS. Frequency: Occasional (HP:0040283). (ORPHA:251056)
- Camptodactyly of finger (HP:0100490): The distal interphalangeal joint and/or the proximal interphalangeal joint of the fingers cannot be extended to 180 degrees by either active or passive extension. Evidence: TAS. Frequency: Occasional (HP:0040283). (ORPHA:251056)